Phenotypes associated with the disease Chronic inflammatory demyelinating polyneuropathy (ORPHA:2932):
- Decreased nerve conduction velocity (HP:0000762): A reduction in the speed at which electrical signals propagate along the axon of a neuron. Evidence: TAS. Frequency: Very frequent (HP:0040281). (ORPHA:2932)
- Areflexia (HP:0001284): Absence of neurologic reflexes such as the knee-jerk reaction. Evidence: TAS. Frequency: Very frequent (HP:0040281). (ORPHA:2932)
- Unsteady gait (HP:0002317). Evidence: TAS. Frequency: Very frequent (HP:0040281). (ORPHA:2932)
- Paresthesia (HP:0003401): Abnormal sensations such as tingling, pricking, or numbness of the skin with no apparent physical cause. Evidence: TAS. Frequency: Very frequent (HP:0040281). (ORPHA:2932)
- Somatic sensory dysfunction (HP:0003474): An abnormality of the primary sensation that is mediated by peripheral nerves (pain, temperature, touch, vibration, joint position). The word hypoesthesia (or hypesthesia) refers to a reduction in cutaneous sensation to a specific type of testing. Evidence: TAS. Frequency: Very frequent (HP:0040281). (ORPHA:2932)
- Segmental peripheral demyelination/remyelination (HP:0003481): A segmental pattern of demyelination and regeneration (remyelination) affecting peripheral nerves. Evidence: TAS. Frequency: Very frequent (HP:0040281). (ORPHA:2932)
- Peripheral neuropathy (HP:0009830): Peripheral neuropathy is a general term for any disorder of the peripheral nervous system. The main clinical features used to classify peripheral neuropathy are distribution, type (mainly demyelinating versus mainly axonal), duration, and course. Evidence: TAS. Frequency: Very frequent (HP:0040281). (ORPHA:2932)
- Sensory ataxia (HP:0010871): Incoordination of movement caused by a deficit in the sensory nervous system. Sensory ataxia can be distinguished from cerebellar ataxia by asking the patient to close his or her eyes. Persons with cerebellar ataxia show only a minimal worsening of symptoms, whereas persons with sensory ataxia show a marked worsening of symptoms. Evidence: TAS. Frequency: Very frequent (HP:0040281). (ORPHA:2932)
- Peripheral demyelination (HP:0011096): A loss of myelin from the internode regions along myelinated nerve fibers of the peripheral nervous system. Evidence: TAS. Frequency: Very frequent (HP:0040281). (ORPHA:2932)
- Motor conduction block (HP:0012078): Blockade of impulses at a focal site along the course of a motor axon. Evidence: TAS. Frequency: Very frequent (HP:0040281). (ORPHA:2932)
- Fatiguable weakness of proximal limb muscles (HP:0030200): A type of weakness of a skeletal muscle of proximal part of a limb that occurs after a muscle group is used and lessens if the muscle group has some rest. That is, there is diminution of strength with repetitive muscle actions. Evidence: TAS. Frequency: Very frequent (HP:0040281). (ORPHA:2932)
- Abnormal nerve conduction velocity (HP:0040129). Evidence: TAS. Frequency: Very frequent (HP:0040281). (ORPHA:2932)
- Falls (HP:0002527). Evidence: TAS. Frequency: Frequent (HP:0040282). (ORPHA:2932)
- Difficulty climbing stairs (HP:0003551): Reduced ability to climb stairs. Evidence: TAS. Frequency: Frequent (HP:0040282). (ORPHA:2932)
- Hand muscle weakness (HP:0030237): Reduced strength of the musculature of the hand. Evidence: TAS. Frequency: Frequent (HP:0040282). (ORPHA:2932)
- Anti-neurofascin-155 antibody positivity (HP:0034135): The presence of autoantibodies (immunoglobulins) in the blood circulation that react against NF155. Evidence: TAS. Frequency: Frequent (HP:0040282). (ORPHA:2932)
- Anti-neurofascin 186 antibody positivity (HP:0034136): The presence of autoantibodies (immunoglobulins) in the blood circulation that react against NF186. Evidence: TAS. Frequency: Frequent (HP:0040282). (ORPHA:2932)
- Anti-contactin-1 antibody positivity (HP:0034137): The presence of autoantibodies (immunoglobulins) in the blood circulation that react against CNTN1. Evidence: TAS. Frequency: Frequent (HP:0040282). (ORPHA:2932)
- Anti-contactin-associated protein 1 antibody positivity (HP:0034138): The presence of autoantibodies (immunoglobulins) in the blood circulation that react against anti-contactin-associated protein 1. Evidence: TAS. Frequency: Frequent (HP:0040282). (ORPHA:2932)
- Spontaneous pain sensation (HP:0010833): Spontaneous pain is a kind of neuropathic pain which occurs without an identifiable trigger. Evidence: TAS. Frequency: Occasional (HP:0040283). (ORPHA:2932)
- Gait disturbance (HP:0001288): The term gait disturbance can refer to any disruption of the ability to walk. Evidence: TAS. Frequency: Frequent (HP:0040282). (ORPHA:2932)